Phenotypes associated with the disease Early-onset seizures-distal limb anomalies-facial dysmorphism-global developmental delay syndrome (ORPHA:505237):
- Seizure (HP:0001250): A seizure is an intermittent abnormality of nervous system physiology characterized by a transient occurrence of signs and/or symptoms due to abnormal excessive or synchronous neuronal activity in the brain. Evidence: TAS. Frequency: Very frequent (HP:0040281). (ORPHA:505237)
- Severe intellectual disability (HP:0010864): Severe intellectual disability (ID) is defined as a type of ID characterized by severely sub-average adaptive functioning and intellectual functioning, with an intelligence quotient (IQ) the range of 20-34. Evidence: TAS. Frequency: Very frequent (HP:0040281). (ORPHA:505237)
- High palate (HP:0000218): Height of the palate more than 2 SD above the mean (objective) or palatal height at the level of the first permanent molar more than twice the height of the teeth (subjective). Evidence: TAS. Frequency: Frequent (HP:0040282). (ORPHA:505237)
- Thin upper lip vermilion (HP:0000219): Height of the vermilion of the upper lip in the midline more than 2 SD below the mean. Alternatively, an apparently reduced height of the vermilion of the upper lip in the frontal view (subjective). Evidence: TAS. Frequency: Frequent (HP:0040282). (ORPHA:505237)
- Brachycephaly (HP:0000248): An abnormality of skull shape characterized by a decreased anterior-posterior diameter. That is, a cephalic index greater than 81%. Alternatively, an apparently shortened anteroposterior dimension (length) of the head compared to width. Evidence: TAS. Frequency: Frequent (HP:0040282). (ORPHA:505237)
- Microcephaly (HP:0000252): Head circumference below 2 standard deviations below the mean for age and gender. Evidence: TAS. Frequency: Frequent (HP:0040282). (ORPHA:505237)
- Long face (HP:0000276): Facial height (length) is more than 2 standard deviations above the mean (objective); or, an apparent increase in the height (length) of the face (subjective). Evidence: TAS. Frequency: Frequent (HP:0040282). (ORPHA:505237)
- Retrognathia (HP:0000278): An abnormality in which the mandible is mislocalised posteriorly. Evidence: TAS. Frequency: Frequent (HP:0040282). (ORPHA:505237)
- Long philtrum (HP:0000343): Distance between nasal base and midline upper lip vermilion border more than 2 SD above the mean. Alternatively, an apparently increased distance between nasal base and midline upper lip vermilion border. Evidence: TAS. Frequency: Frequent (HP:0040282). (ORPHA:505237)
- Hearing impairment (HP:0000365): A decreased magnitude of the sensory perception of sound. Evidence: TAS. Frequency: Frequent (HP:0040282). (ORPHA:505237)
- Low-set ears (HP:0000369): Upper insertion of the ear to the scalp below an imaginary horizontal line drawn between the inner canthi of the eye and extending posteriorly to the ear. Evidence: TAS. Frequency: Frequent (HP:0040282). (ORPHA:505237)
- Macrotia (HP:0000400): Median longitudinal ear length greater than two standard deviations above the mean and median ear width greater than two standard deviations above the mean (objective); or, apparent increase in length and width of the pinna (subjective). Evidence: TAS. Frequency: Frequent (HP:0040282). (ORPHA:505237)
- Prominent nasal bridge (HP:0000426): Anterior positioning of the nasal root in comparison to the usual positioning for age. Evidence: TAS. Frequency: Frequent (HP:0040282). (ORPHA:505237)
- Wide nose (HP:0000445): Interalar distance more than two standard deviations above the mean for age, i.e., an apparently increased width of the nasal base and alae. Evidence: TAS. Frequency: Frequent (HP:0040282). (ORPHA:505237)
- Short neck (HP:0000470): Diminished length of the neck. Evidence: TAS. Frequency: Frequent (HP:0040282). (ORPHA:505237)
- Downslanted palpebral fissures (HP:0000494): The palpebral fissure inclination is more than two standard deviations below the mean. Evidence: TAS. Frequency: Frequent (HP:0040282). (ORPHA:505237)
- Long eyelashes (HP:0000527): Mid upper eyelash length >10 mm or increased length of the eyelashes (subjective). Evidence: TAS. Frequency: Frequent (HP:0040282). (ORPHA:505237)
- Long palpebral fissure (HP:0000637): Distance between medial and lateral canthi is more than two standard deviations above the mean for age (objective); or, apparently increased length of the palpebral fissures. Evidence: TAS. Frequency: Frequent (HP:0040282). (ORPHA:505237)
- Sacral dimple (HP:0000960): A cutaneous indentation resulting from tethering of the skin to underlying structures (bone) of the intergluteal cleft. Evidence: TAS. Frequency: Frequent (HP:0040282). (ORPHA:505237)
- Tapered finger (HP:0001182): The gradual reduction in girth of the finger from proximal to distal. Evidence: TAS. Frequency: Frequent (HP:0040282). (ORPHA:505237)
- Hyperextensibility of the finger joints (HP:0001187): The ability of the finger joints to move beyond their normal range of motion. Evidence: TAS. Frequency: Frequent (HP:0040282). (ORPHA:505237)
- Global developmental delay (HP:0001263): A delay in the achievement of motor or mental milestones in the domains of development of a child, including motor skills, speech and language, cognitive skills, and social and emotional skills. This term should only be used to describe children younger than five years of age. Evidence: TAS. Frequency: Frequent (HP:0040282). (ORPHA:505237)
- Generalized hypotonia (HP:0001290): Generalized muscular hypotonia (abnormally low muscle tone). Evidence: TAS. Frequency: Frequent (HP:0040282). (ORPHA:505237)
- Absent speech (HP:0001344): Complete lack of development of speech and language abilities. Evidence: TAS. Frequency: Frequent (HP:0040282). (ORPHA:505237)
- Failure to thrive (HP:0001508): Failure to thrive (FTT) refers to a child whose physical growth is substantially below the norm. Evidence: TAS. Frequency: Frequent (HP:0040282). (ORPHA:505237)
- Intrauterine growth retardation (HP:0001511): An abnormal restriction of fetal growth with fetal weight below the tenth percentile for gestational age. Evidence: TAS. Frequency: Frequent (HP:0040282). (ORPHA:505237)
- Talipes equinovarus (HP:0001762): Talipes equinovarus (also called clubfoot) typically has four main components: inversion and adduction of the forefoot; inversion of the heel and hindfoot; equinus (limitation of extension) of the ankle and subtalar joint; and internal rotation of the leg. Evidence: TAS. Frequency: Frequent (HP:0040282). (ORPHA:505237)
- Overlapping toe (HP:0001845): Describes a foot digit resting on the dorsal surface of an adjacent digit when the foot is at rest. Initially clawing may be dynamic and only noticeable on walking. Over time the plantar plate tears, subluxation occurs at the metatarsophalangeal joint (MTPJ), and the deformity becomes permanent. Evidence: TAS. Frequency: Frequent (HP:0040282). (ORPHA:505237)
- Ventriculomegaly (HP:0002119): An increase in size of the ventricular system of the brain. Evidence: TAS. Frequency: Frequent (HP:0040282). (ORPHA:505237)
- Inability to walk (HP:0002540): Incapability to ambulate. Evidence: TAS. Frequency: Frequent (HP:0040282). (ORPHA:505237)
- Highly arched eyebrow (HP:0002553): Increased height of the central portion of the eyebrow, forming a crescent, semicircular, or inverted U shape. Evidence: TAS. Frequency: Frequent (HP:0040282). (ORPHA:505237)
- Scoliosis (HP:0002650): The presence of an abnormal lateral curvature of the spine. Evidence: TAS. Frequency: Frequent (HP:0040282). (ORPHA:505237)
- Limb joint contracture (HP:0003121): A contracture (chronic loss of joint motion due to structural changes in muscle, tendons, ligaments, or skin) that prevent normal movement of one or more joints of the limbs. Evidence: TAS. Frequency: Frequent (HP:0040282). (ORPHA:505237)
- Short stature (HP:0004322): A height below that which is expected according to age and gender norms. Although there is no universally accepted definition of short stature, many refer to "short stature" as height more than 2 standard deviations below the mean for age and gender (or below the 3rd percentile for age and gender dependent norms). Evidence: TAS. Frequency: Frequent (HP:0040282). (ORPHA:505237)
- Decreased body weight (HP:0004325): Abnormally low body weight. Evidence: TAS. Frequency: Frequent (HP:0040282). (ORPHA:505237)
- Flat occiput (HP:0005469): Reduced convexity of the occiput (posterior part of skull). Evidence: TAS. Frequency: Frequent (HP:0040282). (ORPHA:505237)
- Aplasia/Hypoplasia of the corpus callosum (HP:0007370): Absence or underdevelopment of the corpus callosum. Evidence: TAS. Frequency: Frequent (HP:0040282). (ORPHA:505237)
- Broad thumb (HP:0011304): Increased thumb width without increased dorso-ventral dimension. Evidence: TAS. Frequency: Frequent (HP:0040282). (ORPHA:505237)
- Feeding difficulties (HP:0011968): Impaired ability to eat related to problems gathering food and getting ready to suck, chew, or swallow it. Evidence: TAS. Frequency: Frequent (HP:0040282). (ORPHA:505237)
- Cryptorchidism (HP:0000028): Testis in inguinal canal. That is, absence of one or both testes from the scrotum owing to failure of the testis or testes to descend through the inguinal canal to the scrotum. Evidence: TAS. Frequency: Occasional (HP:0040283). (ORPHA:505237)
- Autistic behavior (HP:0000729): Persistent deficits in social interaction and communication and interaction as well as a markedly restricted repertoire of activity and interest as well as repetitive patterns of behavior. Evidence: TAS. Frequency: Occasional (HP:0040283). (ORPHA:505237)
- Arachnodactyly (HP:0001166): Abnormally long and slender fingers (spider fingers). Evidence: TAS. Frequency: Occasional (HP:0040283). (ORPHA:505237)
- Ataxia (HP:0001251): Ataxia refers to impaired coordination of voluntary muscle movement. Cerebellar ataxia refers to ataxia due to dysfunction of the cerebellum. This causes a variety of elementary neurological deficits including asynergy (lack of coordination between muscles, limbs and joints), dysmetria (lack of ability to judge distances that can lead to under- or overshoot in grasping movements), and dysdiadochokinesia (inability to perform rapid movements requiring antagonizing muscle groups to be switched on and off repeatedly). Evidence: TAS. Frequency: Occasional (HP:0040283). (ORPHA:505237)
- Spasticity (HP:0001257): A motor disorder characterized by a velocity-dependent increase in tonic stretch reflexes with increased muscle tone, exaggerated (hyperexcitable) tendon reflexes. Evidence: TAS. Frequency: Occasional (HP:0040283). (ORPHA:505237)
- Hypertonia (HP:0001276): A condition in which there is increased muscle tone so that arms or legs, for example, are stiff and difficult to move. Evidence: TAS. Frequency: Occasional (HP:0040283). (ORPHA:505237)
- Ventricular septal defect (HP:0001629): A hole between the two bottom chambers (ventricles) of the heart. The defect is centered around the most superior aspect of the ventricular septum. Evidence: TAS. Frequency: Occasional (HP:0040283). (ORPHA:505237)
- Atrial septal defect (HP:0001631): Atrial septal defect (ASD) is a congenital abnormality of the interatrial septum that enables blood flow between the left and right atria via the interatrial septum. Evidence: TAS. Frequency: Occasional (HP:0040283). (ORPHA:505237)
- Toe syndactyly (HP:0001770): Webbing or fusion of the toes, involving soft parts only or including bone structure. Bony fusions are referred to as "bony" Syndactyly if the fusion occurs in a radio-ulnar axis. Fusions of bones of the toes in a proximo-distal axis are referred to as "Symphalangism". Evidence: TAS. Frequency: Occasional (HP:0040283). (ORPHA:505237)
- Cerebral cortical atrophy (HP:0002120): Atrophy of the cortex of the cerebrum. Evidence: TAS. Frequency: Occasional (HP:0040283). (ORPHA:505237)
- Spastic tetraplegia (HP:0002510): Spastic paralysis affecting all four limbs. Evidence: TAS. Frequency: Occasional (HP:0040283). (ORPHA:505237)
- Aplasia/Hypoplasia of the external ear (HP:0008772): The presence of aplasia or developmental hypoplasia of all or part of the external ear. Evidence: TAS. Frequency: Occasional (HP:0040283). (ORPHA:505237)
- Chronic constipation (HP:0012450): Constipation for longer than three months with fewer than 3 bowel movements per week, straining, lumpy or hard stools, and a sensation of anorectal obstruction or incomplete defecation. Evidence: TAS. Frequency: Occasional (HP:0040283). (ORPHA:505237)
- Cerebral palsy (HP:0100021): Cerebral palsy describes a group of permanent disorders of the development of movement and posture, causing activity limitation, that are attributed to nonprogressive disturbances that occurred in the developing fetal or infant brain. The motor disorders of cerebral palsy are often accompanied by disturbances of sensation, perception, cognition, communication, and behavior, by epilepsy, and by secondary musculoskeletal problems. Evidence: TAS. Frequency: Very rare (HP:0040284). (ORPHA:505237)